- Tremor (HP:0001337): An unintentional, oscillating to-and-fro muscle movement about a joint axis. Evidence: TAS. Frequency: Occasional (HP:0040283). (ORPHA:206443)
- Slurred speech (HP:0001350): Abnormal coordination of muscles involved in speech. Evidence: TAS. Frequency: Occasional (HP:0040283). (ORPHA:206443)
- Pes cavus (HP:0001761): An increase in height of the medial longitudinal arch of the foot that does not flatten on weight bearing (i.e., a distinctly hollow form of the sole of the foot when it is bearing weight). Evidence: TAS. Frequency: Occasional (HP:0040283). (ORPHA:206443)
- Neuromuscular dysphagia (HP:0002068). Evidence: TAS. Frequency: Occasional (HP:0040283). (ORPHA:206443)
- Hemiplegia (HP:0002301): Paralysis (complete loss of muscle function) in the arm, leg, and in some cases the face on one side of the body. Evidence: TAS. Frequency: Occasional (HP:0040283). (ORPHA:206443)
- Febrile seizure (within the age range of 3 months to 6 years) (HP:0002373): A febrile seizure is any type of seizure (most often a generalized tonic-clonic seizure) occurring with fever (at least 38 degrees Celsius) but in the absence of central nervous system infection, severe metabolic disturbance or other alternative precipitant in children between the ages of 3 months and 6 years. Evidence: TAS. Frequency: Occasional (HP:0040283). (ORPHA:206443)
- Tetraplegia (HP:0002445): Paralysis of all four limbs, and trunk of the body below the level of an associated injury to the spinal cord. The etiology of quadriplegia is similar to that of paraplegia except that the lesion is in the cervical spinal cord rather than in the thoracic or lumbar segments of the spinal cord. Evidence: TAS. Frequency: Occasional (HP:0040283). (ORPHA:206443)
- Upper limb muscle weakness (HP:0003484): Weakness of the muscles of the arms. Evidence: TAS. Frequency: Occasional (HP:0040283). (ORPHA:206443)
- Attention deficit hyperactivity disorder (HP:0007018): Attention deficit hyperactivity disorder (ADHD) manifests at age 2-3 years or by first grade at the latest. The main symptoms are distractibility, impulsivity, hyperactivity, and often trouble organizing tasks and projects, difficulty going to sleep, and social problems from being aggressive, loud, or impatient. Evidence: TAS. Frequency: Occasional (HP:0040283). (ORPHA:206443)
- Axial hypotonia (HP:0008936): Muscular hypotonia (abnormally low muscle tone) affecting the musculature of the trunk. Evidence: TAS. Frequency: Occasional (HP:0040283). (ORPHA:206443)
- Impaired tactile sensation (HP:0010830): A reduced sense of touch (tactile sensation). This is usually tested with a wisp of cotton or a fine camel's hair brush, by asking patients to say 'now' each time they feel the stimulus. Evidence: TAS. Frequency: Occasional (HP:0040283). (ORPHA:206443)
- Feeding difficulties (HP:0011968): Impaired ability to eat related to problems gathering food and getting ready to suck, chew, or swallow it. Evidence: TAS. Frequency: Occasional (HP:0040283). (ORPHA:206443)
- Acroparesthesia (HP:0031006): A type of paresthesia (tingling, pins-and-needles, burning or numbness or stiffness) that occurs in the hands and feet and particularly in the fingers and toes. Evidence: TAS. Frequency: Occasional (HP:0040283). (ORPHA:206443)
- Irritability (HP:0000737): An emotional state characterized by negative feelings of heightened frustration, annoyance, or feeling upset, often triggered by internal factors (e.g., fatigue, hunger, unfulfilled desires) or external factors (e.g., social or environmental challenges). Irritability may be unpredictable, and is accompanied by a lowered threshold for emotional reactivity and observable features (speech, facial expressions, or psychomotor activity). Evidence: TAS. Frequency: Very rare (HP:0040284). (ORPHA:206443)
- Increased CSF protein concentration (HP:0002922): Increased concentration of protein in the cerebrospinal fluid. Evidence: TAS. Frequency: Very frequent (HP:0040281). (ORPHA:206443)
- Reduced tissue galactocerebrosidase activity (HP:0034322): Concentration or activity of galactocerebrosidase (EC 3.2.1.46) below the lower limit of normal. This enzyme can be measured in multiple tissues including leukocytes and cultured fibroblasts. Evidence: TAS. Frequency: Very frequent (HP:0040281). (ORPHA:206443)
- Hearing impairment (HP:0000365): A decreased magnitude of the sensory perception of sound. Evidence: TAS. Frequency: Frequent (HP:0040282). (ORPHA:206443)
- Esotropia (HP:0000565): A form of strabismus with one or both eyes turned inward ('crossed') to a relatively severe degree, usually defined as 10 diopters or more. Evidence: TAS. Frequency: Frequent (HP:0040282). (ORPHA:206443)
- Visual loss (HP:0000572): Loss of visual acuity (implying that vision was better at a certain time point in life). Otherwise the term reduced visual acuity should be used (or a subclass of that). Evidence: TAS. Frequency: Frequent (HP:0040282). (ORPHA:206443)
- Abnormality of visual evoked potentials (HP:0000649): An anomaly of visually evoked potentials (VEP), which are electrical potentials, initiated by brief visual stimuli, which are recorded from the scalp overlying the visual cortex. Evidence: TAS. Frequency: Frequent (HP:0040282). (ORPHA:206443)
- Atypical behavior (HP:0000708): Atypical behavior is an abnormality in a person's actions that can be controlled or modulated by the will of the individual. While abnormal behaviors can be difficult to control, they are distinct from other abnormal actions that cannot be affected by the individual's will. Evidence: TAS. Frequency: Frequent (HP:0040282). (ORPHA:206443)
- Decreased nerve conduction velocity (HP:0000762): A reduction in the speed at which electrical signals propagate along the axon of a neuron. Evidence: TAS. Frequency: Frequent (HP:0040282). (ORPHA:206443)
- Spastic diplegia (HP:0001264): Spasticity (neuromuscular hypertonia) primarily in the muscles of the legs, hips, and pelvis. Evidence: TAS. Frequency: Frequent (HP:0040282). (ORPHA:206443)
- Mental deterioration (HP:0001268): Loss of previously present mental abilities, generally in adults. Evidence: TAS. Frequency: Frequent (HP:0040282). (ORPHA:206443)
- Motor delay (HP:0001270): A type of Developmental delay characterized by a delay in acquiring motor skills. Evidence: TAS. Frequency: Frequent (HP:0040282). (ORPHA:206443)
- Gait disturbance (HP:0001288): The term gait disturbance can refer to any disruption of the ability to walk. Evidence: TAS. Frequency: Frequent (HP:0040282). (ORPHA:206443)
- Lower limb spasticity (HP:0002061): Spasticity (velocity-dependent increase in tonic stretch reflexes with increased muscle tone and hyperexcitable tendon reflexes) in the muscles of the lower limbs, hips, and pelvis. Evidence: TAS. Frequency: Frequent (HP:0040282). (ORPHA:206443)
- Clumsiness (HP:0002312): Lack of physical coordination resulting in an abnormal tendency to drop items or bump into objects. Evidence: TAS. Frequency: Frequent (HP:0040282). (ORPHA:206443)
- Spastic paraparesis (HP:0002313): Partial loss of the ability to move the lower limbs accompanied by spasticity of the lower limbs. Evidence: TAS. Frequency: Frequent (HP:0040282). (ORPHA:206443)
- Frequent falls (HP:0002359). Evidence: TAS. Frequency: Frequent (HP:0040282). (ORPHA:206443)
- Loss of speech (HP:0002371). Evidence: TAS. Frequency: Frequent (HP:0040282). (ORPHA:206443)
- Developmental regression (HP:0002376): Loss of developmental skills, as manifested by loss of developmental milestones. Evidence: TAS. Frequency: Frequent (HP:0040282). (ORPHA:206443)
- Upper motor neuron dysfunction (HP:0002493): A functional anomaly of the upper motor neuron. The upper motor neurons are neurons of the primary motor cortex which project to the brainstem and spinal chord via the corticonuclear, corticobulbar and corticospinal (pyramidal) tracts. They are involved in control of voluntary movements. Dysfunction leads to weakness, impairment of fine motor movements, spasticity, hyperreflexia and abnormal pyramidal signs. Evidence: TAS. Frequency: Frequent (HP:0040282). (ORPHA:206443)
- Loss of ambulation (HP:0002505): Inability to walk in a person who previous had the ability to walk. Evidence: TAS. Frequency: Frequent (HP:0040282). (ORPHA:206443)
- Functional motor deficit (HP:0004302). Evidence: TAS. Frequency: Frequent (HP:0040282). (ORPHA:206443)
- Delayed brainstem auditory evoked response conduction time (HP:0004466): An abnormal increase (delay) in the conduction time of the brainstem auditory-evoked response. Evidence: TAS. Frequency: Frequent (HP:0040282). (ORPHA:206443)
- Sensorimotor neuropathy (HP:0007141). Evidence: TAS. Frequency: Frequent (HP:0040282). (ORPHA:206443)
- Peripheral neuropathy (HP:0009830): Peripheral neuropathy is a general term for any disorder of the peripheral nervous system. The main clinical features used to classify peripheral neuropathy are distribution, type (mainly demyelinating versus mainly axonal), duration, and course. Evidence: TAS. Frequency: Frequent (HP:0040282). (ORPHA:206443)
- EEG with persistent abnormal rhythmic activity (HP:0010846). Evidence: TAS. Frequency: Frequent (HP:0040282). (ORPHA:206443)
- Abnormal CNS myelination (HP:0011400): An abnormality of myelination of nerves in the central nervous system. Evidence: TAS. Frequency: Frequent (HP:0040282). (ORPHA:206443)
- Visual impairment (HP:0000505): Visual impairment (or vision impairment) is vision loss (of a person) to such a degree as to qualify as an additional support need through a significant limitation of visual capability resulting from either disease, trauma, or congenital or degenerative conditions that cannot be corrected by conventional means, such as refractive correction, medication, or surgery. Evidence: TAS. Frequency: Occasional (HP:0040283). (ORPHA:206443)
- Blindness (HP:0000618): Blindness is the condition of lacking visual perception defined as a profound reduction in visual perception. On the 6m visual acuity scale, blindness is defined as less than 3/60. On the 20ft visual acuity scale, blindness is defined as less than 20/400. On the decimal visual acuity scale, blindness is defined as less than 0.05. Blindness is typically characterized by a visual field of no greater than 10 degrees in radius around central fixation. Evidence: TAS. Frequency: Occasional (HP:0040283). (ORPHA:206443)
- Emotional lability (HP:0000712): Unstable emotional experiences and frequent mood changes; emotions that are easily aroused, intense, and/or disproportionate to events and circumstances. Evidence: TAS. Frequency: Occasional (HP:0040283). (ORPHA:206443)
- Seizure (HP:0001250): A seizure is an intermittent abnormality of nervous system physiology characterized by a transient occurrence of signs and/or symptoms due to abnormal excessive or synchronous neuronal activity in the brain. Evidence: TAS. Frequency: Occasional (HP:0040283). (ORPHA:206443)
- Ataxia (HP:0001251): Ataxia refers to impaired coordination of voluntary muscle movement. Cerebellar ataxia refers to ataxia due to dysfunction of the cerebellum. This causes a variety of elementary neurological deficits including asynergy (lack of coordination between muscles, limbs and joints), dysmetria (lack of ability to judge distances that can lead to under- or overshoot in grasping movements), and dysdiadochokinesia (inability to perform rapid movements requiring antagonizing muscle groups to be switched on and off repeatedly). Evidence: TAS. Frequency: Occasional (HP:0040283). (ORPHA:206443)
- Dysarthria (HP:0001260): Dysarthric speech is a general description referring to a neurological speech disorder characterized by poor articulation. Depending on the involved neurological structures, dysarthria may be further classified as spastic, flaccid, ataxic, hyperkinetic and hypokinetic, or mixed. Evidence: TAS. Frequency: Occasional (HP:0040283). (ORPHA:206443)
These phenotypes are associated with the disease Late-infantile/juvenile Krabbe disease (ORPHA:206443).